- Epicanthus (HP:0000286): A fold of skin starting above the medial aspect of the upper eyelid and arching downward to cover, pass in front of and lateral to the medial canthus. Evidence: IEA. (OMIM:177990)
- Low posterior hairline (HP:0002162): Hair on the neck extends more inferiorly than usual. Evidence: IEA. (OMIM:177990)
- Short nose (HP:0003196): Distance from nasion to subnasale more than two standard deviations below the mean, or alternatively, an apparently decreased length from the nasal root to the nasal tip. Evidence: IEA. (OMIM:177990)
- Protruding ear (HP:0000411): Angle formed by the plane of the ear and the mastoid bone greater than the 97th centile for age (objective); or, outer edge of the helix more than 2 cm from the mastoid at the point of maximum distance (objective). Evidence: IEA. (OMIM:177990)
- Webbed neck (HP:0000465): Pterygium colli is a congenital skin fold that runs along the sides of the neck down to the shoulders. It involves an ectopic fibrotic facial band superficial to the trapezius muscle. Excess hair-bearing skin is also present and extends down the cervical region well beyond the normal hairline. Evidence: IEA. (OMIM:177990)
- Autosomal dominant inheritance (HP:0000006): A mode of inheritance that is observed for traits related to a gene encoded on one of the autosomes (i.e., the human chromosomes 1-22) in which a trait manifests in heterozygotes. In the context of medical genetics, an autosomal dominant disorder is caused when a single copy of the mutant allele is present. Males and females are affected equally, and can both transmit the disorder with a risk of 50% for each child of inheriting the mutant allele. Evidence: IEA. (OMIM:177990)
These phenotypes are associated with the disease pterygium colli, isolated (OMIM:177990).